- Absent fingernail (HP:0001817): Absence of a fingernail. Evidence: TAS. Frequency: Very frequent (HP:0040281). (ORPHA:3258)
- Frontal bossing (HP:0002007): Bilateral bulging of the lateral frontal bone prominences with relative sparing of the midline. Evidence: TAS. Frequency: Very frequent (HP:0040281). (ORPHA:3258)
- Synostosis of carpal bones (HP:0005048). Evidence: TAS. Frequency: Very frequent (HP:0040281). (ORPHA:3258)
- Abnormal metacarpal morphology (HP:0005916): Any abnormal shape or structure of the metacarpal bones. Evidence: TAS. Frequency: Very frequent (HP:0040281). (ORPHA:3258)
- Finger syndactyly (HP:0006101): Webbing or fusion of the fingers, involving soft parts only or including bone structure. Bony fusions are referred to as "bony" Syndactyly if the fusion occurs in a radio-ulnar axis. Fusions of bones of the fingers in a proximo-distal axis are referred to as "Symphalangism". Evidence: TAS. Frequency: Very frequent (HP:0040281). (ORPHA:3258)
- Oligodactyly (HP:0012165): A developmental defect resulting in the presence of fewer than the normal number of digits. Evidence: TAS. Frequency: Very frequent (HP:0040281). (ORPHA:3258)
- Synostosis of joints (HP:0100240): The abnormal fusion of neighboring bones across a joint. Evidence: TAS. Frequency: Very frequent (HP:0040281). (ORPHA:3258)
- Hypertelorism (HP:0000316): Interpupillary distance more than 2 SD above the mean (alternatively, the appearance of an increased interpupillary distance or widely spaced eyes). Evidence: TAS. Frequency: Frequent (HP:0040282). (ORPHA:3258)
- Downslanted palpebral fissures (HP:0000494): The palpebral fissure inclination is more than two standard deviations below the mean. Evidence: TAS. Frequency: Frequent (HP:0040282). (ORPHA:3258)
- Toe syndactyly (HP:0001770): Webbing or fusion of the toes, involving soft parts only or including bone structure. Bony fusions are referred to as "bony" Syndactyly if the fusion occurs in a radio-ulnar axis. Fusions of bones of the toes in a proximo-distal axis are referred to as "Symphalangism". Evidence: TAS. Frequency: Frequent (HP:0040282). (ORPHA:3258)
- Absent toenail (HP:0001802): Congenital absence of the toenail. Evidence: TAS. Frequency: Frequent (HP:0040282). (ORPHA:3258)
- Radioulnar synostosis (HP:0002974): An abnormal osseous union (fusion) between the radius and the ulna. Evidence: TAS. Frequency: Frequent (HP:0040282). (ORPHA:3258)
- Hypoplasia of the radius (HP:0002984): Underdevelopment of the radius. Evidence: TAS. Frequency: Frequent (HP:0040282). (ORPHA:3258)
- Hypoplasia of the ulna (HP:0003022): Underdevelopment of the ulna. Evidence: TAS. Frequency: Frequent (HP:0040282). (ORPHA:3258)
- Short thumb (HP:0009778): Hypoplasia (congenital reduction in size) of the thumb. Evidence: TAS. Frequency: Frequent (HP:0040282). (ORPHA:3258)
- Malar flattening (HP:0000272): Underdevelopment of the malar prominence of the jugal bone (zygomatic bone in mammals), appreciated in profile, frontal view, and/or by palpation. Evidence: TAS. Frequency: Occasional (HP:0040283). (ORPHA:3258)
- Short philtrum (HP:0000322): Distance between nasal base and midline upper lip vermilion border more than 2 SD below the mean. Alternatively, an apparently decreased distance between nasal base and midline upper lip vermilion border. Evidence: TAS. Frequency: Occasional (HP:0040283). (ORPHA:3258)
- Hearing impairment (HP:0000365): A decreased magnitude of the sensory perception of sound. Evidence: TAS. Frequency: Occasional (HP:0040283). (ORPHA:3258)
- Protruding ear (HP:0000411): Angle formed by the plane of the ear and the mastoid bone greater than the 97th centile for age (objective); or, outer edge of the helix more than 2 cm from the mastoid at the point of maximum distance (objective). Evidence: TAS. Frequency: Occasional (HP:0040283). (ORPHA:3258)
- Convex nasal ridge (HP:0000444): Nasal ridge curving anteriorly to an imaginary line that connects the nasal root and tip. The nose appears often also prominent, and the columella low. Evidence: TAS. Frequency: Occasional (HP:0040283). (ORPHA:3258)
- Ptosis (HP:0000508): The upper eyelid margin is positioned 3 mm or more lower than usual and covers the superior portion of the iris (objective); or, the upper lid margin obscures at least part of the pupil (subjective). Evidence: TAS. Frequency: Occasional (HP:0040283). (ORPHA:3258)
- Cataract (HP:0000518): A cataract is an opacity or clouding that develops in the crystalline lens of the eye or in its capsule. Evidence: TAS. Frequency: Occasional (HP:0040283). (ORPHA:3258)
- Proptosis (HP:0000520): An eye that is protruding anterior to the plane of the face to a greater extent than is typical. Evidence: TAS. Frequency: Occasional (HP:0040283). (ORPHA:3258)
- Nystagmus (HP:0000639): Rhythmic, involuntary oscillations of one or both eyes related to abnormality in fixation, conjugate gaze, or vestibular mechanisms. Evidence: TAS. Frequency: Occasional (HP:0040283). (ORPHA:3258)
- Ectropion (HP:0000656): An outward turning (eversion) or rotation of the eyelid margin. Evidence: TAS. Frequency: Occasional (HP:0040283). (ORPHA:3258)
- Hypodontia (HP:0000668): The absence of five or less teeth from the normal series by a failure to develop. Evidence: TAS. Frequency: Occasional (HP:0040283). (ORPHA:3258)
- Abnormal dental enamel morphology (HP:0000682): An abnormality of the dental enamel. Evidence: TAS. Frequency: Occasional (HP:0040283). (ORPHA:3258)
- Abnormal rib morphology (HP:0000772): An anomaly of the rib. Evidence: TAS. Frequency: Occasional (HP:0040283). (ORPHA:3258)
- Hypothyroidism (HP:0000821): Deficiency of thyroid hormone. Evidence: TAS. Frequency: Occasional (HP:0040283). (ORPHA:3258)
- Laryngomalacia (HP:0001601): Laryngomalacia is a congenital abnormality of the laryngeal cartilage in which the cartilage is floppy and prolapses over the larynx during inspiration. Evidence: TAS. Frequency: Occasional (HP:0040283). (ORPHA:3258)
- Foot oligodactyly (HP:0001849): A developmental defect resulting in the presence of fewer than the normal number of toes. Evidence: TAS. Frequency: Occasional (HP:0040283). (ORPHA:3258)
- Scoliosis (HP:0002650): The presence of an abnormal lateral curvature of the spine. Evidence: TAS. Frequency: Occasional (HP:0040283). (ORPHA:3258)
- High, narrow palate (HP:0002705): The presence of a high and narrow palate. Evidence: TAS. Frequency: Occasional (HP:0040283). (ORPHA:3258)
- Hip dislocation (HP:0002827): Displacement of the femur from its normal location in the hip joint. Evidence: TAS. Frequency: Occasional (HP:0040283). (ORPHA:3258)
- Micromelia (HP:0002983): The presence of abnormally small extremities. Evidence: TAS. Frequency: Occasional (HP:0040283). (ORPHA:3258)
- Elbow dislocation (HP:0003042): Dislocation of the distal humerus out of the elbow joint, where the radius, ulna, and humerus meet. Evidence: TAS. Frequency: Occasional (HP:0040283). (ORPHA:3258)
- Short nose (HP:0003196): Distance from nasion to subnasale more than two standard deviations below the mean, or alternatively, an apparently decreased length from the nasal root to the nasal tip. Evidence: TAS. Frequency: Occasional (HP:0040283). (ORPHA:3258)
- Abnormal vertebral body morphology (HP:0003312): Abnormal form of vertebral body, which is the central cylindrical portion of the vertebra that together with other structures such as the vertebral arch, pedicles, laminae, spinous process, transverse processes, and articular facets makes up a vertebra. Evidence: TAS. Frequency: Occasional (HP:0040283). (ORPHA:3258)
- Crossed fused renal ectopia (HP:0004736): A developmental anomaly in which the kidneys are fused and localized on the same side of the midline. This anomaly is thought to result from disruption of the normal embryologic migration of the kidneys. Evidence: TAS. Frequency: Occasional (HP:0040283). (ORPHA:3258)
- Abnormal dermatoglyphics (HP:0007477): An abnormality of dermatoglyphs (fingerprints), which are present on fingers, palms, toes, and soles. Evidence: TAS. Frequency: Occasional (HP:0040283). (ORPHA:3258)
- Renal hypoplasia/aplasia (HP:0008678): Absence or underdevelopment of the kidney. Evidence: TAS. Frequency: Occasional (HP:0040283). (ORPHA:3258)
These phenotypes are associated with the disease Cenani-Lenz syndrome (ORPHA:3258).